Phenotypes associated with the disease Temple-Baraitser syndrome (ORPHA:420561):
- Everted upper lip vermilion (HP:0010803): Inner aspect of the upper lip vermilion (normally apposing the teeth) visible in a frontal view, i.e., the presence of an everted upper lip. Evidence: TAS. Frequency: Occasional (HP:0040283). (ORPHA:420561)
- Tented upper lip vermilion (HP:0010804): Triangular appearance of the oral aperture with the apex in the midpoint of the upper vermilion and the lower vermilion forming the base. Evidence: TAS. Frequency: Occasional (HP:0040283). (ORPHA:420561)
- Hypoplastic thumbnail (HP:0012553): A thumbnail that is diminished in length and width, i.e., underdeveloped thumb nail. Evidence: TAS. Frequency: Occasional (HP:0040283). (ORPHA:420561)
- Absent nail of hallux (HP:0012555): Absent nail of big toe. Evidence: TAS. Frequency: Occasional (HP:0040283). (ORPHA:420561)
- Wide mouth (HP:0000154): Distance between the oral commissures more than 2 SD above the mean. Alternatively, an apparently increased width of the oral aperture (subjective). Evidence: TAS. Frequency: Frequent (HP:0040282). (ORPHA:420561)
- Microcephaly (HP:0000252): Head circumference below 2 standard deviations below the mean for age and gender. Evidence: TAS. Frequency: Frequent (HP:0040282). (ORPHA:420561)
- Coarse facial features (HP:0000280): Absence of fine and sharp appearance of brows, nose, lips, mouth, and chin, usually because of rounded and heavy features or thickened skin with or without thickening of subcutaneous and bony tissues. Evidence: TAS. Frequency: Frequent (HP:0040282). (ORPHA:420561)
- Epicanthus (HP:0000286): A fold of skin starting above the medial aspect of the upper eyelid and arching downward to cover, pass in front of and lateral to the medial canthus. Evidence: TAS. Frequency: Frequent (HP:0040282). (ORPHA:420561)
- Hypertelorism (HP:0000316): Interpupillary distance more than 2 SD above the mean (alternatively, the appearance of an increased interpupillary distance or widely spaced eyes). Evidence: TAS. Frequency: Frequent (HP:0040282). (ORPHA:420561)
- Long philtrum (HP:0000343): Distance between nasal base and midline upper lip vermilion border more than 2 SD above the mean. Alternatively, an apparently increased distance between nasal base and midline upper lip vermilion border. Evidence: TAS. Frequency: Frequent (HP:0040282). (ORPHA:420561)
- Macrotia (HP:0000400): Median longitudinal ear length greater than two standard deviations above the mean and median ear width greater than two standard deviations above the mean (objective); or, apparent increase in length and width of the pinna (subjective). Evidence: TAS. Frequency: Frequent (HP:0040282). (ORPHA:420561)
- Wide nasal bridge (HP:0000431): Increased breadth of the nasal bridge (and with it, the nasal root). Evidence: TAS. Frequency: Frequent (HP:0040282). (ORPHA:420561)
- Wide nose (HP:0000445): Interalar distance more than two standard deviations above the mean for age, i.e., an apparently increased width of the nasal base and alae. Evidence: TAS. Frequency: Frequent (HP:0040282). (ORPHA:420561)
- Long eyelashes (HP:0000527): Mid upper eyelash length >10 mm or increased length of the eyelashes (subjective). Evidence: TAS. Frequency: Frequent (HP:0040282). (ORPHA:420561)
- Thick eyebrow (HP:0000574): Increased density/number and/or increased diameter of eyebrow hairs. Evidence: TAS. Frequency: Frequent (HP:0040282). (ORPHA:420561)
- Delayed eruption of teeth (HP:0000684): Delayed tooth eruption, which can be defined as tooth eruption more than 2 SD beyond the mean eruption age. Evidence: TAS. Frequency: Frequent (HP:0040282). (ORPHA:420561)
- Seizure (HP:0001250): A seizure is an intermittent abnormality of nervous system physiology characterized by a transient occurrence of signs and/or symptoms due to abnormal excessive or synchronous neuronal activity in the brain. Evidence: TAS. Frequency: Frequent (HP:0040282). (ORPHA:420561)
- Generalized hypotonia (HP:0001290): Generalized muscular hypotonia (abnormally low muscle tone). Evidence: TAS. Frequency: Frequent (HP:0040282). (ORPHA:420561)
- Absent speech (HP:0001344): Complete lack of development of speech and language abilities. Evidence: TAS. Frequency: Frequent (HP:0040282). (ORPHA:420561)
- Bilateral ptosis (HP:0001488). Evidence: TAS. Frequency: Frequent (HP:0040282). (ORPHA:420561)
- Long hallux (HP:0001847): Increased length of the big toe. Evidence: TAS. Frequency: Frequent (HP:0040282). (ORPHA:420561)
- Constipation (HP:0002019): Infrequent or difficult evacuation of feces. Evidence: TAS. Frequency: Frequent (HP:0040282). (ORPHA:420561)
- Myopathic facies (HP:0002058): A facial appearance characteristic of myopathic conditions. The face appears expressionless with sunken cheeks, bilateral ptosis, and inability to elevate the corners of the mouth, due to muscle weakness. Evidence: TAS. Frequency: Frequent (HP:0040282). (ORPHA:420561)
- EEG abnormality (HP:0002353): Abnormality observed by electroencephalogram (EEG), which is used to record of the brain's spontaneous electrical activity from multiple electrodes placed on the scalp. Evidence: TAS. Frequency: Frequent (HP:0040282). (ORPHA:420561)
- Short stature (HP:0004322): A height below that which is expected according to age and gender norms. Although there is no universally accepted definition of short stature, many refer to "short stature" as height more than 2 standard deviations below the mean for age and gender (or below the 3rd percentile for age and gender dependent norms). Evidence: TAS. Frequency: Frequent (HP:0040282). (ORPHA:420561)
- Depressed nasal bridge (HP:0005280): Posterior positioning of the nasal root in relation to the overall facial profile for age. Evidence: TAS. Frequency: Frequent (HP:0040282). (ORPHA:420561)
- Aplastic/hypoplastic toenail (HP:0010624): Absence or underdevelopment of the toenail. Evidence: TAS. Frequency: Frequent (HP:0040282). (ORPHA:420561)
- Severe intellectual disability (HP:0010864): Severe intellectual disability (ID) is defined as a type of ID characterized by severely sub-average adaptive functioning and intellectual functioning, with an intelligence quotient (IQ) the range of 20-34. Evidence: TAS. Frequency: Frequent (HP:0040282). (ORPHA:420561)
- Broad thumb (HP:0011304): Increased thumb width without increased dorso-ventral dimension. Evidence: TAS. Frequency: Frequent (HP:0040282). (ORPHA:420561)
- Severe global developmental delay (HP:0011344): A severe delay in the achievement of motor or mental milestones in the domains of development of a child. Evidence: TAS. Frequency: Frequent (HP:0040282). (ORPHA:420561)
- Abnormal brain morphology (HP:0012443): A structural abnormality of the brain, which has as its parts the forebrain, midbrain, and hindbrain. Evidence: TAS. Frequency: Frequent (HP:0040282). (ORPHA:420561)
- Thick vermilion border (HP:0012471): Increased width of the skin of vermilion border region of upper lip. Evidence: TAS. Frequency: Frequent (HP:0040282). (ORPHA:420561)
- Open mouth (HP:0000194): A facial appearance characterized by a permanently or nearly permanently opened mouth. Evidence: TAS. Frequency: Occasional (HP:0040283). (ORPHA:420561)
- Gingival overgrowth (HP:0000212): Hyperplasia of the gingiva (that is, a thickening of the soft tissue overlying the alveolar ridge. The degree of thickening ranges from involvement of the interdental papillae alone to gingival overgrowth covering the entire tooth crown. Evidence: TAS. Frequency: Occasional (HP:0040283). (ORPHA:420561)
- High palate (HP:0000218): Height of the palate more than 2 SD above the mean (objective) or palatal height at the level of the first permanent molar more than twice the height of the teeth (subjective). Evidence: TAS. Frequency: Occasional (HP:0040283). (ORPHA:420561)
- Everted lower lip vermilion (HP:0000232): An abnormal configuration of the lower lip such that it is turned outward i.e., everted, with the Inner aspect of the lower lip vermilion (normally opposing the teeth) being visible in a frontal view. Evidence: TAS. Frequency: Occasional (HP:0040283). (ORPHA:420561)
- Malar flattening (HP:0000272): Underdevelopment of the malar prominence of the jugal bone (zygomatic bone in mammals), appreciated in profile, frontal view, and/or by palpation. Evidence: TAS. Frequency: Occasional (HP:0040283). (ORPHA:420561)
- Full cheeks (HP:0000293): Increased prominence or roundness of soft tissues between zygomata and mandible. Evidence: TAS. Frequency: Occasional (HP:0040283). (ORPHA:420561)
- Low anterior hairline (HP:0000294): Distance between the hairline (trichion) and the glabella (the most prominent point on the frontal bone above the root of the nose), in the midline, more than two SD below the mean. Alternatively, an apparently decreased distance between the hairline and the glabella. Evidence: TAS. Frequency: Occasional (HP:0040283). (ORPHA:420561)
- Anteverted nares (HP:0000463): Anteriorly-facing nostrils viewed with the head in the Frankfurt horizontal and the eyes of the observer level with the eyes of the subject. This gives the appearance of an upturned nose (upturned nasal tip). Evidence: TAS. Frequency: Occasional (HP:0040283). (ORPHA:420561)
- Absent toenail (HP:0001802): Congenital absence of the toenail. Evidence: TAS. Frequency: Occasional (HP:0040283). (ORPHA:420561)
- Hypoplastic fingernail (HP:0001804): Underdevelopment of a fingernail. Evidence: TAS. Frequency: Occasional (HP:0040283). (ORPHA:420561)
- Delayed phalangeal epiphyseal ossification (HP:0006016): Delay in the process of formation and maturation of the epiphysis of one or more phalanx. Evidence: TAS. Frequency: Occasional (HP:0040283). (ORPHA:420561)
- Triangular shaped distal phalanx of the thumb (HP:0009648): Triangular shaped distal phalanx of the thumb. A triangular or so called delta shaped phalanx is a typical result after a bracket epiphysis of the affected phalanx. Evidence: TAS. Frequency: Occasional (HP:0040283). (ORPHA:420561)
- Short phalanx of the thumb (HP:0009660): Hypoplastic (short) thumb phalanx. Evidence: TAS. Frequency: Occasional (HP:0040283). (ORPHA:420561)
- Short distal phalanx of finger (HP:0009882): Short distance from the end of the finger to the most distal interphalangeal crease or the distal interphalangeal joint flexion point. That is, hypoplasia of one or more of the distal phalanx of finger. Evidence: TAS. Frequency: Occasional (HP:0040283). (ORPHA:420561)
- High anterior hairline (HP:0009890): Distance between the hairline (trichion) and the glabella (the most prominent point on the frontal bone above the root of the nose), in the midline, more than two SD above the mean. Alternatively, an apparently increased distance between the hairline and the glabella. Evidence: TAS. Frequency: Occasional (HP:0040283). (ORPHA:420561)
- Thick nasal alae (HP:0009928): Increase in bulk of the ala nasi. Evidence: TAS. Frequency: Occasional (HP:0040283). (ORPHA:420561)